Phenotypes associated with the disease Hydrocephaly-tall stature-joint laxity syndrome (ORPHA:2181):
- Joint hypermobility (HP:0001382): The capability that a joint (or a group of joints) has to move, passively and/or actively, beyond normal limits along physiological axes. Evidence: TAS. Frequency: Very frequent (HP:0040281). (ORPHA:2181)
- Tall stature (HP:0000098): A height above that which is expected according to age and gender norms. Evidence: TAS. Frequency: Very frequent (HP:0040281). (ORPHA:2181)
- Hydrocephalus (HP:0000238): Hydrocephalus is an active distension of the ventricular system of the brain resulting from inadequate passage of CSF from its point of production within the cerebral ventricles to its point of absorption into the systemic circulation. Evidence: TAS. Frequency: Very frequent (HP:0040281). (ORPHA:2181)
- Arachnodactyly (HP:0001166): Abnormally long and slender fingers (spider fingers). Evidence: TAS. Frequency: Very frequent (HP:0040281). (ORPHA:2181)
- Adducted thumb (HP:0001181): In the resting position, the tip of the thumb is on, or near, the palm, close to the base of the fourth or fifth finger. Evidence: TAS. Frequency: Very frequent (HP:0040281). (ORPHA:2181)
- Disproportionate tall stature (HP:0001519): A tall and slim body build with increased arm span to height ratio (>1.05) and a reduced upper-to-lower segment ratio (<0.85), i.e., unusually long arms and legs. The extremities as well as the hands and feet are unusually slim. Evidence: TAS. Frequency: Very frequent (HP:0040281). (ORPHA:2181)
- Kyphosis (HP:0002808): Exaggerated anterior convexity of the thoracic vertebral column. Evidence: TAS. Frequency: Very frequent (HP:0040281). (ORPHA:2181)
- Gait disturbance (HP:0001288): The term gait disturbance can refer to any disruption of the ability to walk. Evidence: TAS. Frequency: Frequent (HP:0040282). (ORPHA:2181)
- Umbilical hernia (HP:0001537): Protrusion of abdominal contents through a defect in the abdominal wall musculature around the umbilicus. Skin and subcutaneous tissue overlie the defect. Evidence: TAS. Frequency: Frequent (HP:0040282). (ORPHA:2181)
- Aortic regurgitation (HP:0001659): An insufficiency of the aortic valve, leading to regurgitation (backward flow) of blood from the aorta into the left ventricle. Evidence: TAS. Frequency: Frequent (HP:0040282). (ORPHA:2181)
- Frontal bossing (HP:0002007): Bilateral bulging of the lateral frontal bone prominences with relative sparing of the midline. Evidence: TAS. Frequency: Frequent (HP:0040282). (ORPHA:2181)
- Hemiplegia (HP:0002301): Paralysis (complete loss of muscle function) in the arm, leg, and in some cases the face on one side of the body. Evidence: TAS. Frequency: Frequent (HP:0040282). (ORPHA:2181)
- Scoliosis (HP:0002650): The presence of an abnormal lateral curvature of the spine. Evidence: TAS. Frequency: Frequent (HP:0040282). (ORPHA:2181)
- High, narrow palate (HP:0002705): The presence of a high and narrow palate. Evidence: TAS. Frequency: Frequent (HP:0040282). (ORPHA:2181)
- Shoulder dislocation (HP:0003834): A displacement or misalignment of the humerus with respect to the other bones of the should joint. Note that a subluxation is a partial dislocation. Evidence: TAS. Frequency: Frequent (HP:0040282). (ORPHA:2181)